Phenotypes associated with the disease Hemifacial hyperplasia (ORPHA:141145):
- Hemifacial hypertrophy (HP:0005323): Unilateral overgrowth of facial tissues, including muscles, bones and skin. Evidence: TAS. Frequency: Obligate (HP:0040280). (ORPHA:141145)
- Facial asymmetry (HP:0000324): An abnormal difference between the left and right sides of the face. Evidence: TAS. Frequency: Very frequent (HP:0040281). (ORPHA:141145)
- Dental malocclusion (HP:0000689): Dental malocclusion refers to an abnormality of the occlusion, or alignment, of the teeth and the way the upper and lower teeth fit together, resulting in overcrowding of teeth or in abnormal bite patterns. Evidence: TAS. Frequency: Frequent (HP:0040282). (ORPHA:141145)
- Macrodontia (HP:0001572): Increased size of the teeth, which can be defined as a mesiodistal tooth diameter (width) more than 2 SD above mean for age. Alternatively, an apparently increased maximum width of the tooth. Evidence: TAS. Frequency: Frequent (HP:0040282). (ORPHA:141145)
- Deviated nasal septum (HP:0004411): Positioning of the nasal septum to the right or left in contrast to the normal midline position of the nasal septum. Evidence: TAS. Frequency: Frequent (HP:0040282). (ORPHA:141145)
- Thick vermilion border (HP:0012471): Increased width of the skin of vermilion border region of upper lip. Evidence: TAS. Frequency: Frequent (HP:0040282). (ORPHA:141145)
- Hemimacroglossia (HP:0100875): Increased length and width of one half of the tongue. Evidence: TAS. Frequency: Frequent (HP:0040282). (ORPHA:141145)
- Respiratory distress (HP:0002098): Respiratory distress is objectively observable as the physical or emotional consequences from the experience of dyspnea. The physical presentation of respiratory distress is generally referred to as labored breathing, while the sensation of respiratory distress is called shortness of breath or dyspnea. Evidence: TAS. Frequency: Occasional (HP:0040283). (ORPHA:141145)
- Headache (HP:0002315): Cephalgia, or pain sensed in various parts of the head, not confined to the area of distribution of any nerve. Evidence: TAS. Frequency: Occasional (HP:0040283). (ORPHA:141145)
- Impaired mastication (HP:0005216): An abnormal reduction in the ability to masticate (chew), i.e., in the ability to crush and ground food in preparation for swallowing. Evidence: TAS. Frequency: Occasional (HP:0040283). (ORPHA:141145)
- Airway obstruction (HP:0006536): Obstruction of conducting airways of the lung. Evidence: TAS. Frequency: Occasional (HP:0040283). (ORPHA:141145)
- Unilateral deafness (HP:0009900): A unilateral absence of sensory perception of sound. Evidence: TAS. Frequency: Occasional (HP:0040283). (ORPHA:141145)
- Open bite (HP:0010807): Visible space between the dental arches in occlusion. Evidence: TAS. Frequency: Occasional (HP:0040283). (ORPHA:141145)
- Unilateral sensorineural hearing impairment (HP:0025797): A form of sensorineural hearing impairment that affects one ear. Evidence: TAS. Frequency: Occasional (HP:0040283). (ORPHA:141145)
- Jaw pain (HP:0040264): An unpleasant sensation characterized by physical discomfort (such as pricking, throbbing, or aching) localized to the jaw. Evidence: TAS. Frequency: Occasional (HP:0040283). (ORPHA:141145)